- Brachydactyly (HP:0001156): Digits that appear disproportionately short compared to the hand/foot. The word brachydactyly is used here to describe a series distinct patterns of shortened digits (brachydactyly types A-E). This is the sense used here. Evidence: PCS. Frequency: 6/14. (PMID:18611980)
- Myopathy (HP:0003198): A disorder of muscle unrelated to impairment of innervation or neuromuscular junction. Evidence: PCS. Frequency: 1/14. (PMID:18611980)
- Clinodactyly (HP:0030084): An angulation of a digit at an interphalangeal joint in the plane of the palm (finger) or sole (toe). Evidence: TAS. (OMIM:610140)
- Syndactyly (HP:0001159): Webbing or fusion of the fingers or toes, involving soft parts only or including bone structure. Bony fusions are referred to as "bony" syndactyly if the fusion occurs in a radio-ulnar axis. Fusions of bones of the fingers or toes in a proximo-distal axis are referred to as "symphalangism". Evidence: IEA. (OMIM:610140)
- Aplasia of the middle phalanx of the hand (HP:0010239): Absence of one or more middle phalanx of a finger. Evidence: IEA. (OMIM:610140)
- Autosomal dominant inheritance (HP:0000006): A mode of inheritance that is observed for traits related to a gene encoded on one of the autosomes (i.e., the human chromosomes 1-22) in which a trait manifests in heterozygotes. In the context of medical genetics, an autosomal dominant disorder is caused when a single copy of the mutant allele is present. Males and females are affected equally, and can both transmit the disorder with a risk of 50% for each child of inheriting the mutant allele. Evidence: PCS. (PMID:18611980)
- Dilated cardiomyopathy (HP:0001644): Dilated cardiomyopathy (DCM) is defined by the presence of left ventricular dilatation and left ventricular systolic dysfunction in the absence of abnormal loading conditions (hypertension, valve disease) or coronary artery disease sufficient to cause global systolic impairment. Right ventricular dilation and dysfunction may be present but are not necessary for the diagnosis. Evidence: IEA. (OMIM:610140)
These phenotypes are associated with the disease heart-hand syndrome, Slovenian type (OMIM:610140).